Phenotypes associated with the disease Internal carotid absence (ORPHA:981):
- Subarachnoid hemorrhage (HP:0002138): Hemorrhage occurring between the arachnoid mater and the pia mater. Evidence: TAS. Frequency: Frequent (HP:0040282). (ORPHA:981)
- Cerebral ischemia (HP:0002637): Restriction of arterial blood supply to the brain associated with insufficient oxygenation to support the metabolic requirements of the tissue. Evidence: TAS. Frequency: Frequent (HP:0040282). (ORPHA:981)
- Dilatation of the cerebral artery (HP:0004944): The presence of a localized dilatation or ballooning of a cerebral artery. Evidence: TAS. Frequency: Frequent (HP:0040282). (ORPHA:981)
- Headache (HP:0002315): Cephalgia, or pain sensed in various parts of the head, not confined to the area of distribution of any nerve. Evidence: TAS. Frequency: Occasional (HP:0040283). (ORPHA:981)
- Arachnoid cyst (HP:0100702): An extra-parenchymal and intra-arachnoidal collection of fluid with a composition similar to that of cerebrospinal fluid. Evidence: TAS. Frequency: Occasional (HP:0040283). (ORPHA:981)